Phenotypes associated with the disease hereditary papulotranslucent acrokeratoderma (OMIM:101840):
- Fine hair (HP:0002213): Hair that is fine or thin to the touch. Evidence: TAS. (OMIM:101840)
- Allergy (HP:0012393): An allergy is an immune response or reaction to substances that are usually not harmful. Evidence: TAS. (OMIM:101840)
- Skin plaque (HP:0200035): A plaque is a solid, raised, plateau-like (flat-topped) lesion greater than 1 cm in diameter. Evidence: TAS. (OMIM:101840)
- Papule (HP:0200034): A circumscribed, solid elevation of skin with no visible fluid, varying in size from a pinhead to less than 10mm in diameter at the widest point. Evidence: TAS. (OMIM:101840)
- Autosomal dominant inheritance (HP:0000006): A mode of inheritance that is observed for traits related to a gene encoded on one of the autosomes (i.e., the human chromosomes 1-22) in which a trait manifests in heterozygotes. In the context of medical genetics, an autosomal dominant disorder is caused when a single copy of the mutant allele is present. Males and females are affected equally, and can both transmit the disorder with a risk of 50% for each child of inheriting the mutant allele. Evidence: TAS. (OMIM:101840)